Phenotypes associated with the disease spastic ataxia 7 (OMIM:108650):
- Spastic ataxia (HP:0002497). Evidence: IEA. (OMIM:108650)
- Babinski sign (HP:0003487): Upturning of the big toe (and sometimes fanning of the other toes) in response to stimulation of the sole of the foot. If the Babinski sign is present it can indicate damage to the corticospinal tract. Evidence: IEA. (OMIM:108650)
- Congenital miosis (HP:0007728): Abnormal (non-physiological) constriction of the pupil of congenital onset. Evidence: IEA. (OMIM:108650)
- Nystagmus (HP:0000639): Rhythmic, involuntary oscillations of one or both eyes related to abnormality in fixation, conjugate gaze, or vestibular mechanisms. Evidence: IEA. (OMIM:108650)
- Dysarthria (HP:0001260): Dysarthric speech is a general description referring to a neurological speech disorder characterized by poor articulation. Depending on the involved neurological structures, dysarthria may be further classified as spastic, flaccid, ataxic, hyperkinetic and hypokinetic, or mixed. Evidence: IEA. (OMIM:108650)
- Dysdiadochokinesis (HP:0002075): A type of ataxia characterized by the impairment of the ability to perform rapidly alternating movements, such as pronating and supinating his or her hand on the dorsum of the other hand as rapidly as possible. Evidence: TAS. (OMIM:108650)
- Abnormal conjugate eye movement (HP:0000549): Any deviation from the normal motor coordination of the eyes that allows for bilateral fixation on a single object. Evidence: IEA. (OMIM:108650)
- Optic atrophy (HP:0000648): Atrophy of the optic nerve. Optic atrophy results from the death of the retinal ganglion cell axons that comprise the optic nerve and manifesting as a pale optic nerve on fundoscopy. Evidence: TAS. Frequency: Occasional (HP:0040283). (OMIM:108650)
- Autosomal dominant inheritance (HP:0000006): A mode of inheritance that is observed for traits related to a gene encoded on one of the autosomes (i.e., the human chromosomes 1-22) in which a trait manifests in heterozygotes. In the context of medical genetics, an autosomal dominant disorder is caused when a single copy of the mutant allele is present. Males and females are affected equally, and can both transmit the disorder with a risk of 50% for each child of inheriting the mutant allele. Evidence: IEA. (OMIM:108650)
- Hyperreflexia (HP:0001347): Hyperreflexia is the presence of hyperactive stretch reflexes of the muscles. Evidence: IEA. (OMIM:108650)